- Typified by somatic mosaicism (HP:0001442): Description of conditions in which affected individuals typically display somatic mosaicism, i.e., genetically distinct populations of somatic cells in a given organism caused by DNA mutations, epigenetic alterations of DNA, chromosomal abnormalities or the spontaneous reversion of inherited mutations. In many conditions typified by somatic mosaicism, constitutive mutation is lethal and cases are exclusively or predominantly mosaic. Evidence: TAS. (OMIM:254500)
- Amyloid deposition (HP:0011034): Pathologic deposits of specific fibrillar protein aggregates with distinct microscopic properties, particularly affinity for the dye Congo red with typical birefringence. Evidence: TAS. (OMIM:254500)
- Adult onset (HP:0003581): Onset of disease manifestations in adulthood, defined here as at the age of 16 years or later. Evidence: PCS. (PMID:23502783)
- Paraproteinemia (HP:0031047): An abnormal immunoglobulin or part of an Ig (light chain) in the circulation. Paraproteins are typically produced by a clonal population of B-cell derived plasma cells. Evidence: TAS. (OMIM:254500)
- Multiple myeloma (HP:0006775): A malignant plasma cell tumor growing within soft tissue or within the skeleton. Evidence: TAS. (OMIM:254500)
These phenotypes are associated with the disease plasma cell myeloma (OMIM:254500).